Phenotypes associated with the disease Al-Raqad syndrome (OMIM:616459):
- Congenital onset (HP:0003577): A phenotypic abnormality that is present at birth. Evidence: PCS. Frequency: 6/6. (PMID:25712129)
- Microcephaly (HP:0000252): Head circumference below 2 standard deviations below the mean for age and gender. Evidence: PCS. Frequency: 3/3. (PMID:25712129)
- Absent speech (HP:0001344): Complete lack of development of speech and language abilities. Evidence: PCS. Frequency: 1/3. (PMID:25712129)
- Inability to walk (HP:0002540): Incapability to ambulate. Evidence: PCS. Frequency: 1/3. (PMID:25712129)
- Delayed speech and language development (HP:0000750): A degree of language development that is significantly below the norm for a child of a specified age. Evidence: PCS. Frequency: 3/3. (PMID:25712129)
- Brachydactyly (HP:0001156): Digits that appear disproportionately short compared to the hand/foot. The word brachydactyly is used here to describe a series distinct patterns of shortened digits (brachydactyly types A-E). This is the sense used here. Evidence: PCS. Frequency: 3/3. (PMID:25712129)
- Delayed ability to walk (HP:0031936): A failure to achieve the ability to walk at an appropriate developmental stage. Most children learn to walk in a series of stages, and learn to walk short distances independently between 12 and 15 months. Evidence: PCS. Frequency: 3/3. (PMID:25712129)
- Joint hypermobility (HP:0001382): The capability that a joint (or a group of joints) has to move, passively and/or actively, beyond normal limits along physiological axes. Evidence: PCS. Frequency: 3/3. (PMID:25712129)
- Seizure (HP:0001250): A seizure is an intermittent abnormality of nervous system physiology characterized by a transient occurrence of signs and/or symptoms due to abnormal excessive or synchronous neuronal activity in the brain. Evidence: PCS. Frequency: 1/3. (PMID:25712129)
- Deeply set eye (HP:0000490): An eye that is more deeply recessed into the plane of the face than is typical. Evidence: PCS. Frequency: 3/3. (PMID:25712129)
- Narrow mouth (HP:0000160): Distance between the commissures of the mouth more than 2 SD below the mean. Alternatively, an apparently decreased width of the oral aperture (subjective). Evidence: PCS. Frequency: 3/3. (PMID:25712129)
- Gait ataxia (HP:0002066): A type of ataxia characterized by the impairment of the ability to coordinate the movements required for normal walking. Gait ataxia is characteirzed by a wide-based staggering gait with a tendency to fall. Evidence: PCS. Frequency: 1/3. (PMID:25712129)
- Global developmental delay (HP:0001263): A delay in the achievement of motor or mental milestones in the domains of development of a child, including motor skills, speech and language, cognitive skills, and social and emotional skills. This term should only be used to describe children younger than five years of age. Evidence: PCS. Frequency: 3/3. (PMID:25712129)
- Hypopigmentation of the skin (HP:0001010): A reduction of skin color related to a decrease in melanin production and deposition. Evidence: PCS. Frequency: 3/3. (PMID:25712129)
- Hypotonia (HP:0001252): Hypotonia is an abnormally low muscle tone (the amount of tension or resistance to movement in a muscle). Even when relaxed, muscles have a continuous and passive partial contraction which provides some resistance to passive stretching. Hypotonia thus manifests as diminished resistance to passive stretching. Hypotonia is not the same as muscle weakness, although the two conditions can co-exist. Evidence: PCS. Frequency: 3/3. Onset: Congenital onset (HP:0003577). (PMID:25712129)
- Short nose (HP:0003196): Distance from nasion to subnasale more than two standard deviations below the mean, or alternatively, an apparently decreased length from the nasal root to the nasal tip. Evidence: PCS. Frequency: 3/3. (PMID:25712129)
- Flat face (HP:0012368): Absence of concavity or convexity of the face when viewed in profile. Evidence: PCS. Frequency: 3/3. (PMID:25712129)
- Chronic constipation (HP:0012450): Constipation for longer than three months with fewer than 3 bowel movements per week, straining, lumpy or hard stools, and a sensation of anorectal obstruction or incomplete defecation. Evidence: PCS. Frequency: 3/3. (PMID:25712129)
- Autosomal recessive inheritance (HP:0000007): A mode of inheritance that is observed for traits related to a gene encoded on one of the autosomes (i.e., the human chromosomes 1-22) in which a trait manifests in individuals with two pathogenic alleles, either homozygotes (two copies of the same mutant allele) or compound heterozygotes (whereby each copy of a gene has a distinct mutant allele). Evidence: PCS. (PMID:25712129)
- Thin upper lip vermilion (HP:0000219): Height of the vermilion of the upper lip in the midline more than 2 SD below the mean. Alternatively, an apparently reduced height of the vermilion of the upper lip in the frontal view (subjective). Evidence: PCS. Frequency: 3/3. (PMID:25712129)
- Delayed ability to sit (HP:0025336): A failure to achieve the ability to sit at an appropriate developmental stage. Most children sit with support at 6 months of age and sit steadily without support at 9 months of age. Evidence: PCS. Frequency: 3/3. (PMID:25712129)
- Sandal gap (HP:0001852): A widely spaced gap between the first toe (the great toe) and the second toe. Evidence: PCS. Frequency: 3/3. (PMID:25712129)
- Atrial septal defect (HP:0001631): Atrial septal defect (ASD) is a congenital abnormality of the interatrial septum that enables blood flow between the left and right atria via the interatrial septum. Evidence: PCS. Frequency: 3/3. (PMID:25712129)
- Low-set ears (HP:0000369): Upper insertion of the ear to the scalp below an imaginary horizontal line drawn between the inner canthi of the eye and extending posteriorly to the ear. Evidence: PCS. Frequency: 3/3. (PMID:25712129)